Phenotypes associated with the disease punctate palmoplantar keratoderma type 2 (OMIM:175860):
- Porokeratosis (HP:0200044): A clonal disorder of keratinization with one or multiple atrophic patches surrounded by a clinically and histologically distinctive hyperkeratotic ridgelike border called the cornoid lamella. Evidence: PCS. (PMID:2525006)
- Autosomal dominant inheritance (HP:0000006): A mode of inheritance that is observed for traits related to a gene encoded on one of the autosomes (i.e., the human chromosomes 1-22) in which a trait manifests in heterozygotes. In the context of medical genetics, an autosomal dominant disorder is caused when a single copy of the mutant allele is present. Males and females are affected equally, and can both transmit the disorder with a risk of 50% for each child of inheriting the mutant allele. Evidence: PCS. (PMID:2525006)
- Spinous keratoses of palms and soles (HP:0007613). Evidence: PCS. (PMID:2525006)